Phenotypes associated with the disease spastic diplegia and intellectual disability (OMIM:270600):
- Spastic diplegia (HP:0001264): Spasticity (neuromuscular hypertonia) primarily in the muscles of the legs, hips, and pelvis. Evidence: IEA. (OMIM:270600)
- Infantile onset (HP:0003593): Onset of signs or symptoms of disease between 28 days to one year of life. Evidence: IEA. (OMIM:270600)
- Autosomal recessive inheritance (HP:0000007): A mode of inheritance that is observed for traits related to a gene encoded on one of the autosomes (i.e., the human chromosomes 1-22) in which a trait manifests in individuals with two pathogenic alleles, either homozygotes (two copies of the same mutant allele) or compound heterozygotes (whereby each copy of a gene has a distinct mutant allele). Evidence: IEA. (OMIM:270600)
- Intellectual disability (HP:0001249): The term intellectual disability or intellectual developmental disorder is used to describe significantly sub-average intellectual and adaptive functioning based on clinical assessment and as measured by individually administered, appropriately normed, standardized and validated tests of intellectual functioning and adaptive behavior, with onset during the developmental period from infancy through adolescence. Evidence: IEA. (OMIM:270600)